Phenotypes associated with the disease hydrolethalus syndrome 2 (OMIM:614120):
- Cleft palate (HP:0000175): Cleft palate is a developmental defect of the palate resulting from a failure of fusion of the palatine processes and manifesting as a separation of the roof of the mouth (soft and hard palate). Evidence: PCS. Frequency: 2/4. (PMID:21552264)
- Anencephaly (HP:0002323): Anencephaly is a developmental anomaly characterized by a fetus that has no calvarium, with a lack of most or all of the fetus' brain tissue. Anencephaly belongs to a collective group known as neural tube defects (NTD) and is a result of the neural tube failing to close in its rostral end during fetal development. Evidence: PCS. Frequency: 2/4. (PMID:21552264)
- Postaxial hand polydactyly (HP:0001162): Supernumerary digits located at the ulnar side of the hand (that is, on the side with the fifth finger). Evidence: PCS. Frequency: 3/4. (PMID:21552264)
- Agenesis of corpus callosum (HP:0001274): Absence of the corpus callosum as a result of the failure of the corpus callosum to develop, which can be the result of a failure in any one of the multiple steps of callosal development including cellular proliferation and migration, axonal growth or glial patterning at the midline. Evidence: PCS. (PMID:21552264)
- Fetal onset (HP:0011461): Onset prior to birth but after 8 weeks of embryonic development (corresponding to a gestational age of 10 weeks). Evidence: PCS. Frequency: 4/4. (PMID:21552264)
- Autosomal recessive inheritance (HP:0000007): A mode of inheritance that is observed for traits related to a gene encoded on one of the autosomes (i.e., the human chromosomes 1-22) in which a trait manifests in individuals with two pathogenic alleles, either homozygotes (two copies of the same mutant allele) or compound heterozygotes (whereby each copy of a gene has a distinct mutant allele). Evidence: PCS. (PMID:21552264)
- Hydrocephalus (HP:0000238): Hydrocephalus is an active distension of the ventricular system of the brain resulting from inadequate passage of CSF from its point of production within the cerebral ventricles to its point of absorption into the systemic circulation. Evidence: PCS. Frequency: 2/4. (PMID:21552264)
- Molar tooth sign on MRI (HP:0002419): An abnormal appearance of the midbrain in axial magnetic resonance imaging in which the elongated superior cerebellar peduncles give the midbrain an appearance reminiscent of a molar or wisdom tooth. Evidence: PCS. Frequency: 1/1. (PMID:21552264)
- Ventriculomegaly (HP:0002119): An increase in size of the ventricular system of the brain. Evidence: PCS. (PMID:21552264)
- Postaxial foot polydactyly (HP:0001830): Polydactyly of the foot most commonly refers to the presence of six toes on one foot. Postaxial polydactyly affects the lateral ray and the duplication may range from a well-formed articulated digit to a rudimentary digit. Evidence: PCS. Frequency: 2/4. (PMID:21552264)
- Preaxial foot polydactyly (HP:0001841): Duplication of all or part of the first ray. Evidence: PCS. Frequency: 3/4. (PMID:21552264)
- Micrognathia (HP:0000347): Developmental hypoplasia of the mandible. Evidence: PCS. Frequency: 1/4. (PMID:21552264)